Phenotypes associated with the disease Cohen syndrome (ORPHA:193):
- Joint hypermobility (HP:0001382): The capability that a joint (or a group of joints) has to move, passively and/or actively, beyond normal limits along physiological axes. Evidence: TAS. Frequency: Frequent (HP:0040282). (ORPHA:193)
- Abnormality of the dentition (HP:0000164): Any abnormality of the teeth. Evidence: TAS. Frequency: Very frequent (HP:0040281). (ORPHA:193)
- Open mouth (HP:0000194): A facial appearance characterized by a permanently or nearly permanently opened mouth. Evidence: TAS. Frequency: Very frequent (HP:0040281). (ORPHA:193)
- Gingival overgrowth (HP:0000212): Hyperplasia of the gingiva (that is, a thickening of the soft tissue overlying the alveolar ridge. The degree of thickening ranges from involvement of the interdental papillae alone to gingival overgrowth covering the entire tooth crown. Evidence: TAS. Frequency: Very frequent (HP:0040281). (ORPHA:193)
- Microcephaly (HP:0000252): Head circumference below 2 standard deviations below the mean for age and gender. Evidence: TAS. Frequency: Very frequent (HP:0040281). (ORPHA:193)
- Low anterior hairline (HP:0000294): Distance between the hairline (trichion) and the glabella (the most prominent point on the frontal bone above the root of the nose), in the midline, more than two SD below the mean. Alternatively, an apparently decreased distance between the hairline and the glabella. Evidence: TAS. Frequency: Very frequent (HP:0040281). (ORPHA:193)
- Short philtrum (HP:0000322): Distance between nasal base and midline upper lip vermilion border more than 2 SD below the mean. Alternatively, an apparently decreased distance between nasal base and midline upper lip vermilion border. Evidence: TAS. Frequency: Very frequent (HP:0040281). (ORPHA:193)
- Hypoplasia of the maxilla (HP:0000327): Abnormally small dimension of the Maxilla. Usually creating a malocclusion or malalignment between the upper and lower teeth or resulting in a deficient amount of projection of the base of the nose and lower midface region. Evidence: TAS. Frequency: Very frequent (HP:0040281). (ORPHA:193)
- Micrognathia (HP:0000347): Developmental hypoplasia of the mandible. Evidence: TAS. Frequency: Very frequent (HP:0040281). (ORPHA:193)
- Prominent nasal bridge (HP:0000426): Anterior positioning of the nasal root in comparison to the usual positioning for age. Evidence: TAS. Frequency: Very frequent (HP:0040281). (ORPHA:193)
- Abnormal eyelid morphology (HP:0000492): An abnormality of the eyelids. Evidence: TAS. Frequency: Very frequent (HP:0040281). (ORPHA:193)
- Downslanted palpebral fissures (HP:0000494): The palpebral fissure inclination is more than two standard deviations below the mean. Evidence: TAS. Frequency: Very frequent (HP:0040281). (ORPHA:193)
- Abnormal eyelash morphology (HP:0000499): An abnormality of the eyelashes. Evidence: TAS. Frequency: Very frequent (HP:0040281). (ORPHA:193)
- Long eyelashes (HP:0000527): Mid upper eyelash length >10 mm or increased length of the eyelashes (subjective). Evidence: TAS. Frequency: Very frequent (HP:0040281). (ORPHA:193)
- Myopia (HP:0000545): An abnormality of refraction characterized by the ability to see objects nearby clearly, while objects in the distance appear blurry. Evidence: TAS. Frequency: Very frequent (HP:0040281). (ORPHA:193)
- Thick eyebrow (HP:0000574): Increased density/number and/or increased diameter of eyebrow hairs. Evidence: TAS. Frequency: Very frequent (HP:0040281). (ORPHA:193)
- Chorioretinal dystrophy (HP:0001135). Evidence: TAS. Frequency: Very frequent (HP:0040281). (ORPHA:193)
- Arachnodactyly (HP:0001166): Abnormally long and slender fingers (spider fingers). Evidence: TAS. Frequency: Very frequent (HP:0040281). (ORPHA:193)
- Tapered finger (HP:0001182): The gradual reduction in girth of the finger from proximal to distal. Evidence: TAS. Frequency: Very frequent (HP:0040281). (ORPHA:193)
- Intellectual disability (HP:0001249): The term intellectual disability or intellectual developmental disorder is used to describe significantly sub-average intellectual and adaptive functioning based on clinical assessment and as measured by individually administered, appropriately normed, standardized and validated tests of intellectual functioning and adaptive behavior, with onset during the developmental period from infancy through adolescence. Evidence: TAS. Frequency: Very frequent (HP:0040281). (ORPHA:193)
- Hypotonia (HP:0001252): Hypotonia is an abnormally low muscle tone (the amount of tension or resistance to movement in a muscle). Even when relaxed, muscles have a continuous and passive partial contraction which provides some resistance to passive stretching. Hypotonia thus manifests as diminished resistance to passive stretching. Hypotonia is not the same as muscle weakness, although the two conditions can co-exist. Evidence: TAS. Frequency: Very frequent (HP:0040281). (ORPHA:193)
- Global developmental delay (HP:0001263): A delay in the achievement of motor or mental milestones in the domains of development of a child, including motor skills, speech and language, cognitive skills, and social and emotional skills. This term should only be used to describe children younger than five years of age. Evidence: TAS. Frequency: Very frequent (HP:0040281). (ORPHA:193)
- Sandal gap (HP:0001852): A widely spaced gap between the first toe (the great toe) and the second toe. Evidence: TAS. Frequency: Very frequent (HP:0040281). (ORPHA:193)
- Decreased total neutrophil count (HP:0001875): Abnormal decrease of absolute number of neutrophils in the blood, per microlitre, compared to a reference range for a given sex and age-group. Evidence: TAS. Frequency: Very frequent (HP:0040281). (ORPHA:193)
- Abnormal speech pattern (HP:0002167): An abnormality in the sound (volume) or cadence (rate) of speech. Evidence: TAS. Frequency: Very frequent (HP:0040281). (ORPHA:193)
- High, narrow palate (HP:0002705): The presence of a high and narrow palate. Evidence: TAS. Frequency: Very frequent (HP:0040281). (ORPHA:193)
- Tooth agenesis (HP:0009804): The absence of one or more teeth from the normal series by a failure to develop. Evidence: TAS. Frequency: Very frequent (HP:0040281). (ORPHA:193)
- Aplasia/Hypoplasia of the tongue (HP:0010295): Absence or underdevelopment of the tongue. Evidence: TAS. Frequency: Very frequent (HP:0040281). (ORPHA:193)
- Hypoplasia of the zygomatic bone (HP:0010669): Underdevelopment of the zygomatic bone. That is, a reduction in size of the zygomatic bone, including the zygomatic process of the temporal bone of the skull, which forms part of the zygomatic arch. Evidence: TAS. Frequency: Very frequent (HP:0040281). (ORPHA:193)
- Slender toe (HP:0011308): Toes that are disproportionately narrow (reduced girth) for the hand/foot size or build of the individual. Evidence: TAS. Frequency: Very frequent (HP:0040281). (ORPHA:193)
- Delayed puberty (HP:0000823): Passing the age when puberty normally occurs with no physical or hormonal signs of the onset of puberty. Evidence: TAS. Frequency: Frequent (HP:0040282). (ORPHA:193)
- Abnormal skin pigmentation (HP:0001000): An abnormality of the pigmentation of the skin. Evidence: TAS. Frequency: Frequent (HP:0040282). (ORPHA:193)
- Intrauterine growth retardation (HP:0001511): An abnormal restriction of fetal growth with fetal weight below the tenth percentile for gestational age. Evidence: TAS. Frequency: Frequent (HP:0040282). (ORPHA:193)
- Obesity (HP:0001513): Accumulation of substantial excess body fat. Evidence: TAS. Frequency: Frequent (HP:0040282). (ORPHA:193)
- Failure to thrive in infancy (HP:0001531). Evidence: TAS. Frequency: Frequent (HP:0040282). (ORPHA:193)
- Decreased fetal movement (HP:0001558): An abnormal reduction in quantity or strength of fetal movements. Evidence: TAS. Frequency: Frequent (HP:0040282). (ORPHA:193)
- Macrodontia (HP:0001572): Increased size of the teeth, which can be defined as a mesiodistal tooth diameter (width) more than 2 SD above mean for age. Alternatively, an apparently increased maximum width of the tooth. Evidence: TAS. Frequency: Frequent (HP:0040282). (ORPHA:193)
- Weak cry (HP:0001612). Evidence: TAS. Frequency: Frequent (HP:0040282). (ORPHA:193)
- Genu valgum (HP:0002857): The legs angle inward, such that the knees are close together and the ankles far apart. Evidence: TAS. Frequency: Frequent (HP:0040282). (ORPHA:193)
- Cubitus valgus (HP:0002967): Abnormal positioning in which the elbows are turned out. Evidence: TAS. Frequency: Frequent (HP:0040282). (ORPHA:193)
- Clinodactyly of the 5th finger (HP:0004209): Clinodactyly refers to a bending or curvature of the fifth finger in the radial direction (i.e., towards the 4th finger). Evidence: TAS. Frequency: Frequent (HP:0040282). (ORPHA:193)
- Narrow palm (HP:0004283): For children from birth to 4 years of age, the palm width is more than 2 SD below the mean; for children from 4 to 16 years of age the palm width is below the 5th centile; or, the width of the palm appears disproportionately narrow for its length. Evidence: TAS. Frequency: Frequent (HP:0040282). (ORPHA:193)
- Short stature (HP:0004322): A height below that which is expected according to age and gender norms. Although there is no universally accepted definition of short stature, many refer to "short stature" as height more than 2 standard deviations below the mean for age and gender (or below the 3rd percentile for age and gender dependent norms). Evidence: TAS. Frequency: Frequent (HP:0040282). (ORPHA:193)
- Finger syndactyly (HP:0006101): Webbing or fusion of the fingers, involving soft parts only or including bone structure. Bony fusions are referred to as "bony" Syndactyly if the fusion occurs in a radio-ulnar axis. Fusions of bones of the fingers in a proximo-distal axis are referred to as "Symphalangism". Evidence: TAS. Frequency: Frequent (HP:0040282). (ORPHA:193)
- Feeding difficulties in infancy (HP:0008872): Impaired feeding performance of an infant as manifested by difficulties such as weak and ineffective sucking, brief bursts of sucking, and falling asleep during sucking. There may be difficulties with chewing or maintaining attention. Evidence: TAS. Frequency: Frequent (HP:0040282). (ORPHA:193)
- Thick hair (HP:0100874): Increased density of hairs, i.e., and elevated number of hairs per unit area. Evidence: TAS. Frequency: Frequent (HP:0040282). (ORPHA:193)
- Cat cry (HP:0200046): The presence of a characteristic high-pitched cry that sounds similar to the meowing of a kitten. Evidence: TAS. Frequency: Frequent (HP:0040282). (ORPHA:193)
- Cryptorchidism (HP:0000028): Testis in inguinal canal. That is, absence of one or both testes from the scrotum owing to failure of the testis or testes to descend through the inguinal canal to the scrotum. Evidence: TAS. Frequency: Occasional (HP:0040283). (ORPHA:193)
- Preauricular skin tag (HP:0000384): A rudimentary tag of skin often containing ear tissue including a core of cartilage and located just anterior to the auricle (outer part of the ear). Evidence: TAS. Frequency: Occasional (HP:0040283). (ORPHA:193)
- Sensorineural hearing impairment (HP:0000407): A type of hearing impairment in one or both ears related to an abnormal functionality of the cochlear nerve. Evidence: TAS. Frequency: Occasional (HP:0040283). (ORPHA:193)
- Strabismus (HP:0000486): A misalignment of the eyes so that the visual axes deviate from bifoveal fixation. The classification of strabismus may be based on a number of features including the relative position of the eyes, whether the deviation is latent or manifest, intermittent or constant, concomitant or otherwise and according to the age of onset and the relevance of any associated refractive error. Evidence: TAS. Frequency: Occasional (HP:0040283). (ORPHA:193)
- Microphthalmia (HP:0000568): A developmental anomaly characterized by abnormal smallness of one or both eyes. Evidence: TAS. Frequency: Occasional (HP:0040283). (ORPHA:193)
- Iris coloboma (HP:0000612): A coloboma of the iris. Evidence: TAS. Frequency: Occasional (HP:0040283). (ORPHA:193)
- Nystagmus (HP:0000639): Rhythmic, involuntary oscillations of one or both eyes related to abnormality in fixation, conjugate gaze, or vestibular mechanisms. Evidence: TAS. Frequency: Occasional (HP:0040283). (ORPHA:193)
- Optic atrophy (HP:0000648): Atrophy of the optic nerve. Optic atrophy results from the death of the retinal ganglion cell axons that comprise the optic nerve and manifesting as a pale optic nerve on fundoscopy. Evidence: TAS. Frequency: Occasional (HP:0040283). (ORPHA:193)
- Pectus excavatum (HP:0000767): A defect of the chest wall characterized by a depression of the sternum, giving the chest ("pectus") a caved-in ("excavatum") appearance. Evidence: TAS. Frequency: Occasional (HP:0040283). (ORPHA:193)
- Seizure (HP:0001250): A seizure is an intermittent abnormality of nervous system physiology characterized by a transient occurrence of signs and/or symptoms due to abnormal excessive or synchronous neuronal activity in the brain. Evidence: TAS. Frequency: Occasional (HP:0040283). (ORPHA:193)
- Ventricular septal defect (HP:0001629): A hole between the two bottom chambers (ventricles) of the heart. The defect is centered around the most superior aspect of the ventricular septum. Evidence: TAS. Frequency: Occasional (HP:0040283). (ORPHA:193)
- Mitral valve prolapse (HP:0001634): One or both of the leaflets (cusps) of the mitral valve bulges back into the left atrium upon contraction of the left ventricle. Evidence: TAS. Frequency: Occasional (HP:0040283). (ORPHA:193)
- Scoliosis (HP:0002650): The presence of an abnormal lateral curvature of the spine. Evidence: TAS. Frequency: Occasional (HP:0040283). (ORPHA:193)
- Kyphosis (HP:0002808): Exaggerated anterior convexity of the thoracic vertebral column. Evidence: TAS. Frequency: Occasional (HP:0040283). (ORPHA:193)
- Abnormal hip bone morphology (HP:0003272): An abnormality of the hip bone. Evidence: TAS. Frequency: Occasional (HP:0040283). (ORPHA:193)
- Abnormal retinal pigmentation (HP:0007703): Any deviation from the normal pigmentation of the retina. Evidence: TAS. Frequency: Occasional (HP:0040283). (ORPHA:193)
- Aplasia/Hypoplasia of the earlobes (HP:0009906): Absence or underdevelopment of the ear lobes. Evidence: TAS. Frequency: Occasional (HP:0040283). (ORPHA:193)